Phenotypes associated with the disease X-linked intellectual disability, Nascimento type (ORPHA:163956):
- Wide mouth (HP:0000154): Distance between the oral commissures more than 2 SD above the mean. Alternatively, an apparently increased width of the oral aperture (subjective). Evidence: TAS. Frequency: Very frequent (HP:0040281). (ORPHA:163956)
- Dry skin (HP:0000958): Skin characterized by the lack of natural or normal moisture. Evidence: TAS. Frequency: Very frequent (HP:0040281). (ORPHA:163956)
- Delayed gross motor development (HP:0002194): A type of motor delay characterized by a delay in acquiring the ability to control the large muscles of the body for walking, running, sitting, and crawling. Evidence: TAS. Frequency: Very frequent (HP:0040281). (ORPHA:163956)
- Poor speech (HP:0002465). Evidence: TAS. Frequency: Very frequent (HP:0040281). (ORPHA:163956)
- Low hanging columella (HP:0009765): Columella extending inferior to the level of the nasal base, when viewed from the side. Evidence: TAS. Frequency: Very frequent (HP:0040281). (ORPHA:163956)
- Micropenis (HP:0000054): Abnormally small penis. At birth, the normal penis is about 3 cm (stretched length from pubic tubercle to tip of penis) with micropenis less than 2.0-2.5 cm. Evidence: TAS. Frequency: Frequent (HP:0040282). (ORPHA:163956)
- Vesicoureteral reflux (HP:0000076): Abnormal (retrograde) movement of urine from the bladder into ureters or kidneys related to inadequacy of the valvular mechanism at the ureterovesicular junction or other causes. Evidence: TAS. Frequency: Frequent (HP:0040282). (ORPHA:163956)
- Thin vermilion border (HP:0000233): Height of the vermilion of the medial part of the lip more than 2 SD below the mean, or apparently reduced height of the vermilion of the lip in the frontal view. The vermilion is the red part of the lips (and confusingly, the vermilion itself is also often referred to as being equivalent the lips). Evidence: TAS. Frequency: Frequent (HP:0040282). (ORPHA:163956)
- Macrocephaly (HP:0000256): Occipitofrontal (head) circumference greater than 97th centile compared to appropriate, age matched, sex-matched normal standards. Alternatively, a apparently increased size of the cranium. Evidence: TAS. Frequency: Frequent (HP:0040282). (ORPHA:163956)
- Hypertelorism (HP:0000316): Interpupillary distance more than 2 SD above the mean (alternatively, the appearance of an increased interpupillary distance or widely spaced eyes). Evidence: TAS. Frequency: Frequent (HP:0040282). (ORPHA:163956)
- Broad neck (HP:0000475): Increased side-to-side width of the neck. Evidence: TAS. Frequency: Frequent (HP:0040282). (ORPHA:163956)
- Upslanted palpebral fissure (HP:0000582): The palpebral fissure inclination is more than two standard deviations above the mean for age (objective); or, the inclination of the palpebral fissure is greater than typical for age. Evidence: TAS. Frequency: Frequent (HP:0040282). (ORPHA:163956)
- Synophrys (HP:0000664): Meeting of the medial eyebrows in the midline. Evidence: TAS. Frequency: Frequent (HP:0040282). (ORPHA:163956)
- Aggressive behavior (HP:0000718): Behavior or an act aimed at harming a person, animal, or physical property (e.g., acts of physical violence; shouting, swearing, and using harsh language; slashing someone's tires). Evidence: TAS. Frequency: Frequent (HP:0040282). (ORPHA:163956)
- Seizure (HP:0001250): A seizure is an intermittent abnormality of nervous system physiology characterized by a transient occurrence of signs and/or symptoms due to abnormal excessive or synchronous neuronal activity in the brain. Evidence: TAS. Frequency: Frequent (HP:0040282). (ORPHA:163956)
- Ventricular septal defect (HP:0001629): A hole between the two bottom chambers (ventricles) of the heart. The defect is centered around the most superior aspect of the ventricular septum. Evidence: TAS. Frequency: Frequent (HP:0040282). (ORPHA:163956)
- Pes cavus (HP:0001761): An increase in height of the medial longitudinal arch of the foot that does not flatten on weight bearing (i.e., a distinctly hollow form of the sole of the foot when it is bearing weight). Evidence: TAS. Frequency: Frequent (HP:0040282). (ORPHA:163956)
- Short foot (HP:0001773): A measured foot length that is more than 2 SD below the mean for a newborn of 27 - 41 weeks gestation, or foot that is less than the 3rd centile for individuals from birth to 16 years of age (objective). Alternatively, a foot that appears disproportionately short (subjective). Evidence: TAS. Frequency: Frequent (HP:0040282). (ORPHA:163956)
- Low posterior hairline (HP:0002162): Hair on the neck extends more inferiorly than usual. Evidence: TAS. Frequency: Frequent (HP:0040282). (ORPHA:163956)
- Generalized hirsutism (HP:0002230): Abnormally increased hair growth over much of the entire body. Evidence: TAS. Frequency: Frequent (HP:0040282). (ORPHA:163956)
- Abnormal cerebral white matter morphology (HP:0002500): An abnormality of the cerebral white matter. Evidence: TAS. Frequency: Frequent (HP:0040282). (ORPHA:163956)
- Downturned corners of mouth (HP:0002714): A morphological abnormality of the mouth in which the angle of the mouth is downturned. The oral commissures are positioned inferior to the midline labial fissure. Evidence: TAS. Frequency: Frequent (HP:0040282). (ORPHA:163956)
- Neonatal hyperbilirubinemia (HP:0003265): A type of hyperbilirubinemia with neonatal onset. Evidence: TAS. Frequency: Frequent (HP:0040282). (ORPHA:163956)
- Depressed nasal bridge (HP:0005280): Posterior positioning of the nasal root in relation to the overall facial profile for age. Evidence: TAS. Frequency: Frequent (HP:0040282). (ORPHA:163956)
- Wide intermamillary distance (HP:0006610): A larger than usual distance between the left and right nipple. Evidence: TAS. Frequency: Frequent (HP:0040282). (ORPHA:163956)
- Hypointensity of cerebral white matter on MRI (HP:0007103): A darker than expected signal on magnetic resonance imaging emanating from the cerebral white matter. Evidence: TAS. Frequency: Frequent (HP:0040282). (ORPHA:163956)
- Echolalia (HP:0010529): Echolalia is the automatic imitative repetition of sounds, words, or phrases in the absence of explicit awareness. The repeated words or phrases are typically odd or used in a non-social manner. These can be words or phrases that the affected individual has heard or invented. Evidence: TAS. Frequency: Frequent (HP:0040282). (ORPHA:163956)
- Severe intellectual disability (HP:0010864): Severe intellectual disability (ID) is defined as a type of ID characterized by severely sub-average adaptive functioning and intellectual functioning, with an intelligence quotient (IQ) the range of 20-34. Evidence: TAS. Frequency: Frequent (HP:0040282). (ORPHA:163956)
- Chronic constipation (HP:0012450): Constipation for longer than three months with fewer than 3 bowel movements per week, straining, lumpy or hard stools, and a sensation of anorectal obstruction or incomplete defecation. Evidence: TAS. Frequency: Frequent (HP:0040282). (ORPHA:163956)
- Cryptorchidism (HP:0000028): Testis in inguinal canal. That is, absence of one or both testes from the scrotum owing to failure of the testis or testes to descend through the inguinal canal to the scrotum. Evidence: TAS. Frequency: Occasional (HP:0040283). (ORPHA:163956)
- Hypospadias (HP:0000047): Abnormal position of urethral meatus on the ventral penile shaft (underside) characterized by displacement of the urethral meatus from the tip of the glans penis to the ventral surface of the penis, scrotum, or perineum. Evidence: TAS. Frequency: Occasional (HP:0040283). (ORPHA:163956)
- High forehead (HP:0000348): An abnormally increased height of the forehead. Evidence: TAS. Frequency: Occasional (HP:0040283). (ORPHA:163956)
- Hearing impairment (HP:0000365): A decreased magnitude of the sensory perception of sound. Evidence: TAS. Frequency: Occasional (HP:0040283). (ORPHA:163956)
- Macrotia (HP:0000400): Median longitudinal ear length greater than two standard deviations above the mean and median ear width greater than two standard deviations above the mean (objective); or, apparent increase in length and width of the pinna (subjective). Evidence: TAS. Frequency: Occasional (HP:0040283). (ORPHA:163956)
- Underdeveloped nasal alae (HP:0000430): Thinned, deficient, or excessively arched ala nasi. Evidence: TAS. Frequency: Occasional (HP:0040283). (ORPHA:163956)
- Strabismus (HP:0000486): A misalignment of the eyes so that the visual axes deviate from bifoveal fixation. The classification of strabismus may be based on a number of features including the relative position of the eyes, whether the deviation is latent or manifest, intermittent or constant, concomitant or otherwise and according to the age of onset and the relevance of any associated refractive error. Evidence: TAS. Frequency: Occasional (HP:0040283). (ORPHA:163956)
- Developmental cataract (HP:0000519): A cataract that occurs congenitally as the result of a developmental defect, in contrast to the majority of cataracts that occur in adulthood as the result of degenerative changes of the lens. Evidence: TAS. Frequency: Occasional (HP:0040283). (ORPHA:163956)
- Compulsive behaviors (HP:0000722): Behavior that consists of repetitive acts, characterized by the feeling that one "has to" perform them, while being aware that these acts are not in line with one's overall goal. Evidence: TAS. Frequency: Occasional (HP:0040283). (ORPHA:163956)
- Oligohydramnios (HP:0001562): Diminished amniotic fluid volume in pregnancy. Evidence: TAS. Frequency: Occasional (HP:0040283). (ORPHA:163956)
- Tetralogy of Fallot (HP:0001636): A congenital cardiac malformation comprising pulmonary stenosis, overriding aorta, ventricular septum defect, and right ventricular hypertrophy. The diagnosis of TOF is made if at least three of the four above mentioned features are present. Evidence: TAS. Frequency: Occasional (HP:0040283). (ORPHA:163956)
- Patent ductus arteriosus (HP:0001643): In utero, the ductus arteriosus (DA) serves to divert ventricular output away from the lungs and toward the placenta by connecting the main pulmonary artery to the descending aorta. A patent ductus arteriosus (PDA) in the first 3 days of life is a physiologic shunt in healthy term and preterm newborn infants, and normally is substantially closed within about 24 hours after bith and completely closed after about three weeks. Failure of physiologcal closure is referred to a persistent or patent ductus arteriosus (PDA). Depending on the degree of left-to-right shunting, PDA can have clinical consequences. Evidence: TAS. Frequency: Occasional (HP:0040283). (ORPHA:163956)
- Patent foramen ovale (HP:0001655): Failure of the foramen ovale to seal postnatally, leaving a potential conduit between the left and right cardiac atria. Evidence: TAS. Frequency: Occasional (HP:0040283). (ORPHA:163956)
- Mitral stenosis (HP:0001718): An abnormal narrowing of the orifice of the mitral valve. Evidence: TAS. Frequency: Occasional (HP:0040283). (ORPHA:163956)
- Double outlet right ventricle (HP:0001719): Double outlet right ventricle (DORV) is a type of ventriculoarterial connection in which both great vessels arise entirely or predominantly from the right ventricle. Evidence: TAS. Frequency: Occasional (HP:0040283). (ORPHA:163956)
- Bilateral talipes equinovarus (HP:0001776): Bilateral clubfoot deformity. Evidence: TAS. Frequency: Occasional (HP:0040283). (ORPHA:163956)
- Overlapping toe (HP:0001845): Describes a foot digit resting on the dorsal surface of an adjacent digit when the foot is at rest. Initially clawing may be dynamic and only noticeable on walking. Over time the plantar plate tears, subluxation occurs at the metatarsophalangeal joint (MTPJ), and the deformity becomes permanent. Evidence: TAS. Frequency: Occasional (HP:0040283). (ORPHA:163956)
- Decreased total neutrophil count (HP:0001875): Abnormal decrease of absolute number of neutrophils in the blood, per microlitre, compared to a reference range for a given sex and age-group. Evidence: TAS. Frequency: Occasional (HP:0040283). (ORPHA:163956)
- Deep philtrum (HP:0002002): Accentuated, prominent philtral ridges giving rise to an exaggerated groove in the midline between the nasal base and upper vermillion border. Evidence: TAS. Frequency: Occasional (HP:0040283). (ORPHA:163956)
- Pulmonary arterial hypertension (HP:0002092): Pulmonary hypertension is defined mean pulmonary artery pressure of 25mmHg or more and pulmonary capillary wedge pressure of 15mmHg or less when measured by right heart catheterisation at rest and in a supine position. Evidence: TAS. Frequency: Occasional (HP:0040283). (ORPHA:163956)
- Recurrent respiratory infections (HP:0002205): An increased susceptibility to respiratory infections as manifested by a history of recurrent respiratory infections. Evidence: TAS. Frequency: Occasional (HP:0040283). (ORPHA:163956)
- Moderate intellectual disability (HP:0002342): Moderate intellectual disability (ID) is defined as a type of ID characterized by moderately sub-average adaptive functioning and intellectual functioning, with an intelligence quotient (IQ) the range of 35-49. Evidence: TAS. Frequency: Occasional (HP:0040283). (ORPHA:163956)
- Preauricular pit (HP:0004467): Small indentation anterior to the insertion of the ear. Evidence: TAS. Frequency: Occasional (HP:0040283). (ORPHA:163956)
- Peripheral pulmonary artery stenosis (HP:0004969): Stenosis of a peripheral branch of the pulmonary artery. Evidence: TAS. Frequency: Occasional (HP:0040283). (ORPHA:163956)
- Abnormal vena cava morphology (HP:0005345): An abnormality of the structure of the veins that return deoxygenated blood from the body into the heart, i.e., the superior vena cava and the inferior vena cava. Evidence: TAS. Frequency: Occasional (HP:0040283). (ORPHA:163956)
- Patchy hypo- and hyperpigmentation (HP:0007509). Evidence: TAS. Frequency: Occasional (HP:0040283). (ORPHA:163956)
- Nail dystrophy (HP:0008404): Onychodystrophy (nail dystrophy) refers to nail changes apart from changes of the color (nail dyschromia) and involves partial or complete disruption of the various keratinous layers of the nail plate. Evidence: TAS. Frequency: Occasional (HP:0040283). (ORPHA:163956)
- Abnormal hair whorl (HP:0010721): An abnormal hair whorl (that is, a patch of hair growing in the opposite direction of the rest of the hair). Evidence: TAS. Frequency: Occasional (HP:0040283). (ORPHA:163956)
- Midface retrusion (HP:0011800): Posterior positions and/or vertical shortening of the infraorbital and perialar regions, or increased concavity of the face and/or reduced nasolabial angle. Evidence: TAS. Frequency: Occasional (HP:0040283). (ORPHA:163956)
- Lumbar hypertrichosis (HP:0011913): Excessive, increased hair growth located in the lumbar region. Evidence: TAS. Frequency: Occasional (HP:0040283). (ORPHA:163956)
- Hypoplasia of the pons (HP:0012110): Underdevelopment of the pons. Evidence: TAS. Frequency: Occasional (HP:0040283). (ORPHA:163956)
- Lower extremity joint dislocation (HP:0030311): Displacement or malalignment of one or more joints in the lower extremity (leg). Evidence: TAS. Frequency: Occasional (HP:0040283). (ORPHA:163956)
- Clubbing of toes (HP:0100760): Terminal broadening of the toes (distal phalanges of the toes). Evidence: TAS. Frequency: Occasional (HP:0040283). (ORPHA:163956)
- Recurrent cutaneous abscess formation (HP:0100838): An increased susceptibility to cutaneous abscess formation, as manifested by a medical history of recurrent cutaneous abscesses. Evidence: TAS. Frequency: Occasional (HP:0040283). (ORPHA:163956)
- Recurrent ear infections (HP:0410018): Increased susceptibility to ear infections as manifested by recurrent episodes of ear infections. Evidence: TAS. Frequency: Occasional (HP:0040283). (ORPHA:163956)